- Fused labia minora (HP:0000063): Fusion of the labia minora as a result of labial adhesions resulting in vaginal obstruction. Evidence: TAS. Frequency: Very frequent (HP:0040281). (ORPHA:250977)
- Wide mouth (HP:0000154): Distance between the oral commissures more than 2 SD above the mean. Alternatively, an apparently increased width of the oral aperture (subjective). Evidence: TAS. Frequency: Very frequent (HP:0040281). (ORPHA:250977)
- Thin upper lip vermilion (HP:0000219): Height of the vermilion of the upper lip in the midline more than 2 SD below the mean. Alternatively, an apparently reduced height of the vermilion of the upper lip in the frontal view (subjective). Evidence: TAS. Frequency: Very frequent (HP:0040281). (ORPHA:250977)
- Brachycephaly (HP:0000248): An abnormality of skull shape characterized by a decreased anterior-posterior diameter. That is, a cephalic index greater than 81%. Alternatively, an apparently shortened anteroposterior dimension (length) of the head compared to width. Evidence: TAS. Frequency: Very frequent (HP:0040281). (ORPHA:250977)
- Low-set ears (HP:0000369): Upper insertion of the ear to the scalp below an imaginary horizontal line drawn between the inner canthi of the eye and extending posteriorly to the ear. Evidence: TAS. Frequency: Very frequent (HP:0040281). (ORPHA:250977)
- Seizure (HP:0001250): A seizure is an intermittent abnormality of nervous system physiology characterized by a transient occurrence of signs and/or symptoms due to abnormal excessive or synchronous neuronal activity in the brain. Evidence: TAS. Frequency: Very frequent (HP:0040281). (ORPHA:250977)
- Congenital blindness (HP:0007875): Blindness with onset at birth. Evidence: TAS. Frequency: Very frequent (HP:0040281). (ORPHA:250977)
- Clitoral hypertrophy (HP:0008665): Hypertrophy of the clitoris. Evidence: TAS. Frequency: Very frequent (HP:0040281). (ORPHA:250977)
- Severe intellectual disability (HP:0010864): Severe intellectual disability (ID) is defined as a type of ID characterized by severely sub-average adaptive functioning and intellectual functioning, with an intelligence quotient (IQ) the range of 20-34. Evidence: TAS. Frequency: Very frequent (HP:0040281). (ORPHA:250977)
- Prominent forehead (HP:0011220): Forward prominence of the entire forehead, due to protrusion of the frontal bone. Evidence: TAS. Frequency: Very frequent (HP:0040281). (ORPHA:250977)
These phenotypes are associated with the disease AICA-ribosiduria (ORPHA:250977).